- Bilateral tonic-clonic seizure (HP:0002069): A bilateral tonic-clonic seizure is a seizure defined by a tonic (bilateral increased tone, lasting seconds to minutes) and then a clonic (bilateral sustained rhythmic jerking) phase. Evidence: PCS. Frequency: 1/1. (PMID:24272827)
- Microcephaly (HP:0000252): Head circumference below 2 standard deviations below the mean for age and gender. Evidence: PCS. Frequency: 1/6. (PMID:20890276)
- Status epilepticus (HP:0002133): Status epilepticus is a type of prolonged seizure resulting either from the failure of the mechanisms responsible for seizure termination or from the initiation of mechanisms which lead to abnormally prolonged seizures (after time point t1). It is a condition that can have long-term consequences (after time point t2), including neuronal death, neuronal injury, and alteration of neuronal networks, depending on the type and duration of seizures. Evidence: PCS. Frequency: 1/1. (PMID:24272827)
- EEG abnormality (HP:0002353): Abnormality observed by electroencephalogram (EEG), which is used to record of the brain's spontaneous electrical activity from multiple electrodes placed on the scalp. Evidence: PCS. Frequency: 3/6. (PMID:20890276)
- Choanal atresia (HP:0000453): Absence or abnormal closure of the choana (the posterior nasal aperture). Most embryologists believe that posterior choanal atresia results from a failure of rupture between the 35th and 38th day of fetal life of the partition which separates the bucconasal or buccopharyngeal membranes. The resultant choanal atresia may be unilateral or bilateral, bony or membranous, complete or incomplete. In over 90 per cent of cases the obstruction is bony, while in the remainder it is membranous. The bony type of atresia is commonly located 1-2 mm. anterior to the posterior edge of the hard palate, and the osseous septum varies in thickness from 1 to 10 mm. In the membranous form of choanal atresia the obstruction usually occurs further posteriorly. In approximately one third of cases the atresia is bilateral. Evidence: PCS. Frequency: 1/6. (PMID:20890276)
- Inguinal hernia (HP:0000023): Protrusion of the contents of the abdominal cavity through the inguinal canal. Evidence: PCS. Frequency: 1/6. (PMID:20890276)
- Dystonia (HP:0001332): An abnormally increased muscular tone that causes fixed abnormal postures. There is a slow, intermittent twisting motion that leads to exaggerated turning and posture of the extremities and trunk. Evidence: IEA. (OMIM:613970)
- Seizure (HP:0001250): A seizure is an intermittent abnormality of nervous system physiology characterized by a transient occurrence of signs and/or symptoms due to abnormal excessive or synchronous neuronal activity in the brain. Evidence: PCS. Frequency: 0/6. (PMID:20890276)
- Focal impaired awareness seizure (HP:0002384): Focal impaired awareness seizure (or focal seizure with impaired or lost awareness) is a type of focal-onset seizure characterized by some degree (which may be partial) of impairment of the person's awareness of themselves or their surroundings at any point during the seizure. Evidence: PCS. Frequency: 1/1. (PMID:24272827)
- Global developmental delay (HP:0001263): A delay in the achievement of motor or mental milestones in the domains of development of a child, including motor skills, speech and language, cognitive skills, and social and emotional skills. This term should only be used to describe children younger than five years of age. Evidence: PCS. Frequency: 1/1. (PMID:24272827)
- Generalized hypotonia (HP:0001290): Generalized muscular hypotonia (abnormally low muscle tone). Evidence: IEA. (OMIM:613970)
- Chorea (HP:0002072): Chorea (Greek for 'dance') refers to widespread arrhythmic involuntary movements of a forcible, jerky and restless fashion. It is a random-appearing sequence of one or more discrete involuntary movements or movement fragments. Movements appear random because of variability in timing, duration or location. Each movement may have a distinct start and end. However, movements may be strung together and thus may appear to flow randomly from one muscle group to another. Chorea can involve the trunk, neck, face, tongue, and extremities. Evidence: IEA. (OMIM:613970)
- Dyskinesia (HP:0100660): A movement disorder which consists of effects including diminished voluntary movements and the presence of involuntary movements. Evidence: IEA. (OMIM:613970)
- Atypical behavior (HP:0000708): Atypical behavior is an abnormality in a person's actions that can be controlled or modulated by the will of the individual. While abnormal behaviors can be difficult to control, they are distinct from other abnormal actions that cannot be affected by the individual's will. Evidence: PCS. Frequency: 6/6. (PMID:20890276)
- Hypothyroidism (HP:0000821): Deficiency of thyroid hormone. Evidence: PCS. Frequency: 1/6. (PMID:20890276)
- Spasticity (HP:0001257): A motor disorder characterized by a velocity-dependent increase in tonic stretch reflexes with increased muscle tone, exaggerated (hyperexcitable) tendon reflexes. Evidence: IEA. (OMIM:613970)
- Pes planus (HP:0001763): A foot where the longitudinal arch of the foot is in contact with the ground or floor when the individual is standing; or, in a patient lying supine, a foot where the arch is in contact with the surface of a flat board pressed against the sole of the foot by the examiner with a pressure similar to that expected from weight bearing; or, the height of the arch is reduced. Evidence: PCS. Frequency: 1/6. (PMID:20890276)
- Intellectual disability (HP:0001249): The term intellectual disability or intellectual developmental disorder is used to describe significantly sub-average intellectual and adaptive functioning based on clinical assessment and as measured by individually administered, appropriately normed, standardized and validated tests of intellectual functioning and adaptive behavior, with onset during the developmental period from infancy through adolescence. Evidence: PCS. Frequency: 7/7. (PMID:20890276;PMID:24272827)
- Cryptorchidism (HP:0000028): Testis in inguinal canal. That is, absence of one or both testes from the scrotum owing to failure of the testis or testes to descend through the inguinal canal to the scrotum. Evidence: PCS. Frequency: 1/4. (PMID:20890276)
- Autosomal dominant inheritance (HP:0000006): A mode of inheritance that is observed for traits related to a gene encoded on one of the autosomes (i.e., the human chromosomes 1-22) in which a trait manifests in heterozygotes. In the context of medical genetics, an autosomal dominant disorder is caused when a single copy of the mutant allele is present. Males and females are affected equally, and can both transmit the disorder with a risk of 50% for each child of inheriting the mutant allele. Evidence: PCS. (PMID:20890276)
These phenotypes are associated with the disease intellectual disability, autosomal dominant 6 (OMIM:613970).